- Epicanthus (HP:0000286): A fold of skin starting above the medial aspect of the upper eyelid and arching downward to cover, pass in front of and lateral to the medial canthus. Evidence: PCS. Frequency: 2/5. (PMID:17704777)
- Congenital onset (HP:0003577): A phenotypic abnormality that is present at birth. Evidence: PCS. Frequency: 5/5. (PMID:17704777)
- Hearing impairment (HP:0000365): A decreased magnitude of the sensory perception of sound. Evidence: PCS. Frequency: 1/5. (PMID:17704777)
- Brachydactyly (HP:0001156): Digits that appear disproportionately short compared to the hand/foot. The word brachydactyly is used here to describe a series distinct patterns of shortened digits (brachydactyly types A-E). This is the sense used here. Evidence: PCS. Frequency: 1/5. (PMID:17704777)
- Short stature (HP:0004322): A height below that which is expected according to age and gender norms. Although there is no universally accepted definition of short stature, many refer to "short stature" as height more than 2 standard deviations below the mean for age and gender (or below the 3rd percentile for age and gender dependent norms). Evidence: PCS. Frequency: 1/5. (PMID:17704777)
- Anteverted nares (HP:0000463): Anteriorly-facing nostrils viewed with the head in the Frankfurt horizontal and the eyes of the observer level with the eyes of the subject. This gives the appearance of an upturned nose (upturned nasal tip). Evidence: PCS. Frequency: 3/5. (PMID:17704777)
- Hypotonia (HP:0001252): Hypotonia is an abnormally low muscle tone (the amount of tension or resistance to movement in a muscle). Even when relaxed, muscles have a continuous and passive partial contraction which provides some resistance to passive stretching. Hypotonia thus manifests as diminished resistance to passive stretching. Hypotonia is not the same as muscle weakness, although the two conditions can co-exist. Evidence: PCS. Frequency: 3/5. (PMID:17704777)
- Short nose (HP:0003196): Distance from nasion to subnasale more than two standard deviations below the mean, or alternatively, an apparently decreased length from the nasal root to the nasal tip. Evidence: PCS. Frequency: 2/5. (PMID:17704777)
- Glossoptosis (HP:0000162): Posterior displacement of the tongue into the pharynx, i.e., a tongue that is mislocalised posteriorly. Evidence: PCS. Frequency: 1/5. (PMID:17704777)
- Gastroesophageal reflux (HP:0002020): A condition in which the stomach contents leak backwards from the stomach into the esophagus through the lower esophageal sphincter. Evidence: PCS. Frequency: 4/5. (PMID:17704777)
- Short palpebral fissure (HP:0012745): Distance between the medial and lateral canthi is more than 2 SD below the mean for age (objective); or, apparently reduced length of the palpebral fissures. Evidence: PCS. Frequency: 2/5. (PMID:17704777)
- Flat face (HP:0012368): Absence of concavity or convexity of the face when viewed in profile. Evidence: PCS. Frequency: 3/5. (PMID:17704777)
- Autism (HP:0000717): Autism is a neurodevelopmental disorder characterized by impaired social interaction and communication, and by restricted and repetitive behavior. Autism begins in childhood. It is marked by the presence of markedly abnormal or impaired development in social interaction and communication and a markedly restricted repertoire of activity and interest. Manifestations of the disorder vary greatly depending on the developmental level and chronological age of the individual (DSM-IV). Evidence: PCS. Frequency: 0/5. (PMID:17704777)
- Hypertelorism (HP:0000316): Interpupillary distance more than 2 SD above the mean (alternatively, the appearance of an increased interpupillary distance or widely spaced eyes). Evidence: PCS. Frequency: 1/5. (PMID:17704777)
- Single transverse palmar crease (HP:0000954): The distal and proximal transverse palmar creases are merged into a single transverse palmar crease. Evidence: PCS. Frequency: 3/5. (PMID:17704777)
- Bulbous nose (HP:0000414): Increased volume and globular shape of the anteroinferior aspect of the nose. Evidence: PCS. Frequency: 1/5. (PMID:17704777)
- Thin upper lip vermilion (HP:0000219): Height of the vermilion of the upper lip in the midline more than 2 SD below the mean. Alternatively, an apparently reduced height of the vermilion of the upper lip in the frontal view (subjective). Evidence: PCS. Frequency: 1/5. (PMID:17704777)
- Clinodactyly (HP:0030084): An angulation of a digit at an interphalangeal joint in the plane of the palm (finger) or sole (toe). Evidence: TAS. (OMIM:613604)
- High palate (HP:0000218): Height of the palate more than 2 SD above the mean (objective) or palatal height at the level of the first permanent molar more than twice the height of the teeth (subjective). Evidence: PCS. Frequency: 1/5. (PMID:17704777)
- Sporadic (HP:0003745): Cases of the disease in question occur without a previous family history, i.e., as isolated cases without being transmitted from a parent and without other siblings being affected. Evidence: PCS. (PMID:17704777)
- Intellectual disability (HP:0001249): The term intellectual disability or intellectual developmental disorder is used to describe significantly sub-average intellectual and adaptive functioning based on clinical assessment and as measured by individually administered, appropriately normed, standardized and validated tests of intellectual functioning and adaptive behavior, with onset during the developmental period from infancy through adolescence. Evidence: PCS. Frequency: 5/5. (PMID:17704777)
- Posteriorly rotated ears (HP:0000358): A type of abnormal location of the ears in which the position of the ears is characterized by posterior rotation (the superior part of the ears is rotated towards the back of the head, and the inferior part of the ears towards the front). Evidence: PCS. Frequency: 3/5. (PMID:17704777)
- Downslanted palpebral fissures (HP:0000494): The palpebral fissure inclination is more than two standard deviations below the mean. Evidence: PCS. Frequency: 3/5. (PMID:17704777)
- Wide nasal bridge (HP:0000431): Increased breadth of the nasal bridge (and with it, the nasal root). Evidence: PCS. Frequency: 2/5. (PMID:17704777)
- Long face (HP:0000276): Facial height (length) is more than 2 standard deviations above the mean (objective); or, an apparent increase in the height (length) of the face (subjective). Evidence: PCS. Frequency: 1/5. (PMID:17704777)
- Feeding difficulties (HP:0011968): Impaired ability to eat related to problems gathering food and getting ready to suck, chew, or swallow it. Evidence: PCS. Frequency: 5/5. (PMID:17704777)
- Open mouth (HP:0000194): A facial appearance characterized by a permanently or nearly permanently opened mouth. Evidence: PCS. Frequency: 1/5. (PMID:17704777)
- Deeply set eye (HP:0000490): An eye that is more deeply recessed into the plane of the face than is typical. Evidence: PCS. Frequency: 2/5. (PMID:17704777)
- Global developmental delay (HP:0001263): A delay in the achievement of motor or mental milestones in the domains of development of a child, including motor skills, speech and language, cognitive skills, and social and emotional skills. This term should only be used to describe children younger than five years of age. Evidence: PCS. Frequency: 5/5. (PMID:17704777)
- Narrow palpebral fissure (HP:0045025): Reduction in the vertical distance between the upper and lower eyelids. Evidence: PCS. Frequency: 2/5. (PMID:17704777)
- Camptodactyly (HP:0012385): The distal interphalangeal joint and/or the proximal interphalangeal joint of the fingers or toes cannot be extended to 180 degrees by either active or passive extension. Evidence: PCS. Frequency: 2/5. (PMID:17704777)
- High forehead (HP:0000348): An abnormally increased height of the forehead. Evidence: PCS. Frequency: 1/5. (PMID:17704777)
- Hypotelorism (HP:0000601): Interpupillary distance less than 2 SD below the mean (alternatively, the appearance of an decreased interpupillary distance or closely spaced eyes). Evidence: PCS. Frequency: 2/5. (PMID:17704777)
- Recurrent otitis media (HP:0000403): Increased susceptibility to otitis media, as manifested by recurrent episodes of otitis media. Evidence: PCS. Frequency: 4/5. (PMID:17704777)
- Frontal bossing (HP:0002007): Bilateral bulging of the lateral frontal bone prominences with relative sparing of the midline. Evidence: PCS. Frequency: 2/5. (PMID:17704777)
- Intrauterine growth retardation (HP:0001511): An abnormal restriction of fetal growth with fetal weight below the tenth percentile for gestational age. Evidence: PCS. Frequency: 0/5. (PMID:17704777)
- Growth delay (HP:0001510): A deficiency or slowing down of growth pre- and postnatally. Evidence: PCS. Frequency: 2/5. (PMID:17704777)
- Pierre-Robin sequence (HP:0000201): Pierre Robin malformation is a sequence of developmental malformations characterized by micrognathia (mandibular hypoplasia), glossoptosis and cleft palate. Evidence: PCS. Frequency: 1/5. (PMID:17704777)
- Low-set ears (HP:0000369): Upper insertion of the ear to the scalp below an imaginary horizontal line drawn between the inner canthi of the eye and extending posteriorly to the ear. Evidence: PCS. Frequency: 2/5. (PMID:17704777)
- Micrognathia (HP:0000347): Developmental hypoplasia of the mandible. Evidence: PCS. Frequency: 1/5. (PMID:17704777)
These phenotypes are associated with the disease chromosome 16p12.2-p11.2 deletion syndrome (OMIM:613604).